Phenotypes associated with the disease Acquired hypertrichosis lanuginosa (ORPHA:2221):
- Abnormal eyelid morphology (HP:0000492): An abnormality of the eyelids. Evidence: TAS. Frequency: Very frequent (HP:0040281). (ORPHA:2221)
- Abnormal eyebrow morphology (HP:0000534): An abnormality of the eyebrow. Evidence: TAS. Frequency: Very frequent (HP:0040281). (ORPHA:2221)
- Fine hair (HP:0002213): Hair that is fine or thin to the touch. Evidence: TAS. Frequency: Very frequent (HP:0040281). (ORPHA:2221)
- Generalized hirsutism (HP:0002230): Abnormally increased hair growth over much of the entire body. Evidence: TAS. Frequency: Very frequent (HP:0040281). (ORPHA:2221)
- Neoplasm (HP:0002664): An organ or organ-system abnormality that consists of uncontrolled autonomous cell-proliferation which can occur in any part of the body as a benign or malignant neoplasm (tumor). Evidence: TAS. Frequency: Very frequent (HP:0040281). (ORPHA:2221)
- Hypopigmentation of hair (HP:0005599). Evidence: TAS. Frequency: Very frequent (HP:0040281). (ORPHA:2221)
- Macroglossia (HP:0000158): Increased length and width of the tongue. Evidence: TAS. Frequency: Frequent (HP:0040282). (ORPHA:2221)
- Glossitis (HP:0000206): Inflammation of the tongue. Evidence: TAS. Frequency: Frequent (HP:0040282). (ORPHA:2221)
- Acanthosis nigricans (HP:0000956): A dermatosis characterized by thickened, hyperpigmented plaques, typically on the intertriginous surfaces and neck. Evidence: TAS. Frequency: Occasional (HP:0040283). (ORPHA:2221)
- Thickened skin (HP:0001072): Laminar thickening of skin. Evidence: TAS. Frequency: Occasional (HP:0040283). (ORPHA:2221)
- Weight loss (HP:0001824): Reduction of total body weight. Evidence: TAS. Frequency: Occasional (HP:0040283). (ORPHA:2221)
- Chronic diarrhea (HP:0002028): The presence of chronic diarrhea, which is usually taken to mean diarrhea that has persisted for over 4 weeks. Evidence: TAS. Frequency: Occasional (HP:0040283). (ORPHA:2221)
- Lymphadenopathy (HP:0002716): Enlargement (swelling) of a lymph node. Evidence: TAS. Frequency: Occasional (HP:0040283). (ORPHA:2221)
- Poor appetite (HP:0004396): A reduced desire to eat. Evidence: TAS. Frequency: Occasional (HP:0040283). (ORPHA:2221)
- Ichthyosis (HP:0008064): An abnormality of the skin characterized the presence of excessive amounts of dry surface scales on the skin resulting from an abnormality of keratinization. Evidence: TAS. Frequency: Occasional (HP:0040283). (ORPHA:2221)
- Neoplasm of the breast (HP:0100013): A tumor (abnormal growth of tissue) of the breast. Evidence: TAS. Frequency: Occasional (HP:0040283). (ORPHA:2221)
- Neoplasm of the respiratory system (HP:0100606): A tumor (abnormal growth of tissue) of the respiratory system. Evidence: TAS. Frequency: Occasional (HP:0040283). (ORPHA:2221)
- Ovarian neoplasm (HP:0100615): A tumor (abnormal growth of tissue) of the ovary. Evidence: TAS. Frequency: Occasional (HP:0040283). (ORPHA:2221)